- Ventricular tachycardia (HP:0004756): A tachycardia originating in the ventricles characterized by rapid heart rate (over 100 beats per minute) and broad QRS complexes (over 120 ms). Evidence: TAS. Frequency: Obligate (HP:0040280). (ORPHA:45453)
- Congestive heart failure (HP:0001635): The presence of an abnormality of cardiac function that is responsible for the failure of the heart to pump blood at a rate that is commensurate with the needs of the tissues or a state in which abnormally elevated filling pressures are required for the heart to do so. Heart failure is frequently related to a defect in myocardial contraction. Evidence: TAS. Frequency: Very frequent (HP:0040281). (ORPHA:45453)
- Cardiac arrest (HP:0001695): An abrupt loss of heart function. Evidence: TAS. Frequency: Very frequent (HP:0040281). (ORPHA:45453)
- Prolonged QRS complex (HP:0006677): Increased time for the complex comprised of the Q wave, R wave, and S wave as measured by the electrocardiogram (EKG).. In adults, normal values are 0.06 - 0.10 sec. Evidence: TAS. Frequency: Very frequent (HP:0040281). (ORPHA:45453)
- Bundle branch block (HP:0011710): Block of conduction of electrical impulses along the Bundle of His or along one of its bundle branches. Evidence: TAS. Frequency: Very frequent (HP:0040281). (ORPHA:45453)
- Abnormal P wave (HP:0031595): Any anomaly of the P wave of the EKG, which results from atrial depolarization. The P wave occurs when the sinoatrial node creates an action potential that depolarizes the atria. Evidence: TAS. Frequency: Very frequent (HP:0040281). (ORPHA:45453)
- Prenatal movement abnormality (HP:0001557): An abnormality of fetal movement. Evidence: TAS. Frequency: Frequent (HP:0040282). (ORPHA:45453)
- Supraventricular tachycardia (HP:0004755): Supraventricular tachycardia (SVT) is an abnormally increased heart rate (over 100 beats per minute at rest) with origin above the level of the ventricles. Evidence: TAS. Frequency: Frequent (HP:0040282). (ORPHA:45453)
- Histiocytoid cardiomyopathy (HP:0005152): A type of cardiomyopathy characterized pathologically by hamartomatous lesions of cardiac Purkinje cells. Evidence: TAS. Frequency: Frequent (HP:0040282). (ORPHA:45453)
- Cardiac rhabdomyoma (HP:0009729): A benign tumor of cardiac striated muscle. Evidence: TAS. Frequency: Frequent (HP:0040282). (ORPHA:45453)
- Wolff-Parkinson-White syndrome (HP:0001716): A disorder of the cardiac conduction system of the heart characterized by ventricular preexcitation due to the presence of an abnormal accessory atrioventricular electrical conduction pathway. Evidence: TAS. Frequency: Occasional (HP:0040283). (ORPHA:45453)
These phenotypes are associated with the disease Incessant infant ventricular tachycardia (ORPHA:45453).
The following phenotypes are NOT associated with this disease:
- Left ventricular systolic dysfunction (HP:0025169): Abnormality of left ventricular contraction, often defined operationally as an ejection fraction of less than 40 percent. Evidence: TAS. (ORPHA:45453)